- Arachnodactyly (HP:0001166): Abnormally long and slender fingers (spider fingers). Evidence: PCS. Frequency: 8/10. (PMID:31587868)
- Scoliosis (HP:0002650): The presence of an abnormal lateral curvature of the spine. Evidence: PCS. Frequency: 6/10. (PMID:31587868)
- Talipes equinovarus (HP:0001762): Talipes equinovarus (also called clubfoot) typically has four main components: inversion and adduction of the forefoot; inversion of the heel and hindfoot; equinus (limitation of extension) of the ankle and subtalar joint; and internal rotation of the leg. Evidence: PCS. Frequency: 1/10. (PMID:31587868)
- Long face (HP:0000276): Facial height (length) is more than 2 standard deviations above the mean (objective); or, an apparent increase in the height (length) of the face (subjective). Evidence: PCS. Frequency: 8/10. (PMID:31587868)
- Open mouth (HP:0000194): A facial appearance characterized by a permanently or nearly permanently opened mouth. Evidence: PCS. Frequency: 7/10. (PMID:31587868)
- Joint hypermobility (HP:0001382): The capability that a joint (or a group of joints) has to move, passively and/or actively, beyond normal limits along physiological axes. Evidence: PCS. Frequency: 9/10. (PMID:31587868)
- Global developmental delay (HP:0001263): A delay in the achievement of motor or mental milestones in the domains of development of a child, including motor skills, speech and language, cognitive skills, and social and emotional skills. This term should only be used to describe children younger than five years of age. Evidence: PCS. Frequency: 10/10. (PMID:31587868)
- Hypotonia (HP:0001252): Hypotonia is an abnormally low muscle tone (the amount of tension or resistance to movement in a muscle). Even when relaxed, muscles have a continuous and passive partial contraction which provides some resistance to passive stretching. Hypotonia thus manifests as diminished resistance to passive stretching. Hypotonia is not the same as muscle weakness, although the two conditions can co-exist. Evidence: PCS. Frequency: 10/10. (PMID:31587868)
- Midface retrusion (HP:0011800): Posterior positions and/or vertical shortening of the infraorbital and perialar regions, or increased concavity of the face and/or reduced nasolabial angle. Evidence: PCS. Frequency: 7/10. (PMID:31587868)
- Abdominal obesity (HP:0012743): Excessive fat around the stomach and abdomen. Evidence: PCS. Frequency: 5/10. (PMID:31587868)
- Camptodactyly (HP:0012385): The distal interphalangeal joint and/or the proximal interphalangeal joint of the fingers or toes cannot be extended to 180 degrees by either active or passive extension. Evidence: PCS. Frequency: 4/10. (PMID:31587868)
- Disproportionate tall stature (HP:0001519): A tall and slim body build with increased arm span to height ratio (>1.05) and a reduced upper-to-lower segment ratio (<0.85), i.e., unusually long arms and legs. The extremities as well as the hands and feet are unusually slim. Evidence: PCS. Frequency: 10/10. Onset: Childhood onset (HP:0011463). (PMID:31587868)
- Ventricular septal defect (HP:0001629): A hole between the two bottom chambers (ventricles) of the heart. The defect is centered around the most superior aspect of the ventricular septum. Evidence: PCS. Frequency: 1/10. (PMID:31587868)
- X-linked recessive inheritance (HP:0001419): A mode of inheritance that is observed for recessive traits related to a gene encoded on the X chromosome. In the context of medical genetics, X-linked recessive disorders manifest in males (who have one copy of the X chromosome and are thus hemizygotes), but generally not in female heterozygotes who have one mutant and one normal allele. Evidence: PCS. (PMID:31587868)
- Aggressive behavior (HP:0000718): Behavior or an act aimed at harming a person, animal, or physical property (e.g., acts of physical violence; shouting, swearing, and using harsh language; slashing someone's tires). Evidence: PCS. (PMID:31587868)
- Pectus excavatum (HP:0000767): A defect of the chest wall characterized by a depression of the sternum, giving the chest ("pectus") a caved-in ("excavatum") appearance. Evidence: PCS. Frequency: 1/10. (PMID:31587868)
- Aortic root aneurysm (HP:0002616): An abnormal localized widening (dilatation) of the aortic root. Evidence: PCS. Frequency: 1/10. (PMID:31587868)
- Pectus carinatum (HP:0000768): A deformity of the chest caused by overgrowth of the ribs and characterized by protrusion of the sternum. Evidence: PCS. Frequency: 3/10. (PMID:31587868)
- Protruding ear (HP:0000411): Angle formed by the plane of the ear and the mastoid bone greater than the 97th centile for age (objective); or, outer edge of the helix more than 2 cm from the mastoid at the point of maximum distance (objective). Evidence: PCS. Frequency: 8/10. (PMID:31587868)
- Short philtrum (HP:0000322): Distance between nasal base and midline upper lip vermilion border more than 2 SD below the mean. Alternatively, an apparently decreased distance between nasal base and midline upper lip vermilion border. Evidence: PCS. Frequency: 7/10. (PMID:31587868)
- Attention deficit hyperactivity disorder (HP:0007018): Attention deficit hyperactivity disorder (ADHD) manifests at age 2-3 years or by first grade at the latest. The main symptoms are distractibility, impulsivity, hyperactivity, and often trouble organizing tasks and projects, difficulty going to sleep, and social problems from being aggressive, loud, or impatient. Evidence: PCS. (PMID:31587868)
- Mitral regurgitation (HP:0001653): An abnormality of the mitral valve characterized by insufficiency or incompetence of the mitral valve resulting in retrograde leaking of blood through the mitral valve upon ventricular contraction. Evidence: PCS. Frequency: 3/10. Onset: Childhood onset (HP:0011463). (PMID:31587868)
- Atrial septal defect (HP:0001631): Atrial septal defect (ASD) is a congenital abnormality of the interatrial septum that enables blood flow between the left and right atria via the interatrial septum. Evidence: PCS. Frequency: 1/10. (PMID:31587868)
- Cryptorchidism (HP:0000028): Testis in inguinal canal. That is, absence of one or both testes from the scrotum owing to failure of the testis or testes to descend through the inguinal canal to the scrotum. Evidence: PCS. Frequency: 4/10. (PMID:31587868)
These phenotypes are associated with the disease intellectual developmental disorder, X-linked, syndromic, Hackmann-Di Donato type (OMIM:301039).